Phenotypes associated with the disease ataxia, deafness, and cardiomyopathy (OMIM:208750):
- Sensorineural hearing impairment (HP:0000407): A type of hearing impairment in one or both ears related to an abnormal functionality of the cochlear nerve. Evidence: IEA. (OMIM:208750)
- Ataxia (HP:0001251): Ataxia refers to impaired coordination of voluntary muscle movement. Cerebellar ataxia refers to ataxia due to dysfunction of the cerebellum. This causes a variety of elementary neurological deficits including asynergy (lack of coordination between muscles, limbs and joints), dysmetria (lack of ability to judge distances that can lead to under- or overshoot in grasping movements), and dysdiadochokinesia (inability to perform rapid movements requiring antagonizing muscle groups to be switched on and off repeatedly). Evidence: IEA. (OMIM:208750)
- Autosomal recessive inheritance (HP:0000007): A mode of inheritance that is observed for traits related to a gene encoded on one of the autosomes (i.e., the human chromosomes 1-22) in which a trait manifests in individuals with two pathogenic alleles, either homozygotes (two copies of the same mutant allele) or compound heterozygotes (whereby each copy of a gene has a distinct mutant allele). Evidence: IEA. (OMIM:208750)
- Cardiomyopathy (HP:0001638): A myocardial disorder in which the heart muscle is structurally and functionally abnormal, in the absence of coronary artery disease, hypertension, valvular disease and congenital heart disease sufficient to cause the observed myocardial abnormality. Evidence: IEA. (OMIM:208750)
- Intellectual disability (HP:0001249): The term intellectual disability or intellectual developmental disorder is used to describe significantly sub-average intellectual and adaptive functioning based on clinical assessment and as measured by individually administered, appropriately normed, standardized and validated tests of intellectual functioning and adaptive behavior, with onset during the developmental period from infancy through adolescence. Evidence: IEA. (OMIM:208750)
- Abnormality of the skin (HP:0000951): An abnormality of the skin. Evidence: IEA. (OMIM:208750)